- Juvenile onset (HP:0003621): Onset of signs or symptoms of disease between the age of 5 and 15 years. Evidence: PCS. Frequency: 1/2. (PMID:21989597)
- Decreased circulating C-peptide concentration (HP:0030795): The concentration of C-peptide in the blood circulation is below the lower limit of normal. Evidence: PCS. Frequency: 1/1. (PMID:34014594)
- Polyneuropathy (HP:0001271): A generalized disorder of peripheral nerves. Evidence: PCS. Frequency: 1/1. (PMID:34014594)
- Moderate albuminuria (HP:0012594): The presence of moderately increased concentrations of albumin in the urine, defined as and albumin-creatinine ratio (ACR) of 30 to 299 mg/gm (3.4 to 34 mg/mmol). Evidence: PCS. Frequency: 1/1. (PMID:34014594)
- Polydipsia (HP:0001959): Excessive thirst manifested by excessive fluid intake. Evidence: PCS. Frequency: 0/1. (PMID:34014594)
- Transient neonatal diabetes mellitus (HP:0008255). Evidence: PCS. Frequency: 0/2. (PMID:21989597)
- Young adult onset (HP:0011462): Onset of disease at the age of between 16 and 40 years. Evidence: PCS. Frequency: 2/3. (PMID:21989597;PMID:34014594)
- Hypertension (HP:0000822): The presence of chronic increased pressure in the systemic arterial system. Evidence: PCS. Frequency: 0/1. (PMID:34014594)
- Maturity-onset diabetes of the young (HP:0004904): The term Maturity-onset diabetes of the young (MODY) was initially used for patients diagnosed with fasting hyperglycemia that could be treated without insulin for more than two years, where the initial diagnosis was made at a young age (under 25 years). Thus, MODY combines characteristics of type 1 diabetes (young age at diagnosis) and type 2 diabetes (less insulin dependence than type 1 diabetes). The term MODY is now most often used to refer to a group of monogenic diseases with these characteristics. Here, the term is used to describe hyperglycemia diagnosed at a young age with no or minor insulin dependency, no evidence of insulin resistance, and lack of evidence of autoimmune destruction of the beta cells. Evidence: PCS. Frequency: 3/3. (PMID:21989597;PMID:34014594)
- Elevated hemoglobin A1c (HP:0040217): An increased concentration of hemoglobin A1c (HbA1c), which is the product of nonenzymatic attachment of a hexose molecule to the N-terminal amino acid of the hemoglobin molecule. This reaction is dependent on blood glucose concentration, and therefore reflects the mean glucose concentration over the previous 8 to 12 weeks. The HbA1c level provides a better indication of long-term glycemic control than one-time blood or urinary glucose measurements. Evidence: PCS. Frequency: 3/3. (PMID:21989597;PMID:34014594)
- Polyuria (HP:0000103): An increased rate of urine production. Evidence: PCS. Frequency: 0/1. (PMID:34014594)
- Retinopathy (HP:0000488): Any noninflammatory disease of the retina. This nonspecific term is retained here because of its wide use in the literature, but if possible new annotations should indicate the precise type of retinal abnormality. Evidence: PCS. Frequency: 1/1. (PMID:34014594)
- Abnormal circulating lipid concentration (HP:0003119): Any deviation from the normal concentration of a lipid in the blood circulation. Evidence: PCS. Frequency: 1/1. (PMID:34014594)
- Diabetic ketoacidosis (HP:0001953): A type of diabetic metabolic abnormality with an accumulation of ketone bodies. Evidence: PCS. Frequency: 0/3. (PMID:21989597;PMID:34014594)
- Obesity (HP:0001513): Accumulation of substantial excess body fat. Evidence: PCS. Frequency: 0/2. (PMID:21989597)
- Autosomal dominant inheritance (HP:0000006): A mode of inheritance that is observed for traits related to a gene encoded on one of the autosomes (i.e., the human chromosomes 1-22) in which a trait manifests in heterozygotes. In the context of medical genetics, an autosomal dominant disorder is caused when a single copy of the mutant allele is present. Males and females are affected equally, and can both transmit the disorder with a risk of 50% for each child of inheriting the mutant allele. Evidence: PCS. (PMID:21989597)
- Osteomyelitis (HP:0002754): Osteomyelitis is an inflammatory process accompanied by bone destruction and caused by an infecting microorganism. Evidence: PCS. Frequency: 1/1. (PMID:34014594)
These phenotypes are associated with the disease maturity-onset diabetes of the young, type 12 (OMIM:621196).